Phenotypes associated with the disease ataxia, intention tremor, and hypotonia syndrome, childhood-onset (OMIM:619352):
- Scoliosis (HP:0002650): The presence of an abnormal lateral curvature of the spine. Evidence: PCS. Frequency: 2/4. (PMID:33783914)
- Dysmetria (HP:0001310): A type of ataxia characterized by the inability to carry out movements with the correct range and motion across the plane of more than one joint related to incorrect estimation of the distances required for targeted movements. Evidence: PCS. Frequency: 1/4. Onset: Young adult onset (HP:0011462). (PMID:33783914)
- Dysarthria (HP:0001260): Dysarthric speech is a general description referring to a neurological speech disorder characterized by poor articulation. Depending on the involved neurological structures, dysarthria may be further classified as spastic, flaccid, ataxic, hyperkinetic and hypokinetic, or mixed. Evidence: PCS. Frequency: 1/4. Onset: Young adult onset (HP:0011462). (PMID:33783914)
- Hypotonia (HP:0001252): Hypotonia is an abnormally low muscle tone (the amount of tension or resistance to movement in a muscle). Even when relaxed, muscles have a continuous and passive partial contraction which provides some resistance to passive stretching. Hypotonia thus manifests as diminished resistance to passive stretching. Hypotonia is not the same as muscle weakness, although the two conditions can co-exist. Evidence: PCS. Frequency: 4/4. (PMID:33783914)
- Global developmental delay (HP:0001263): A delay in the achievement of motor or mental milestones in the domains of development of a child, including motor skills, speech and language, cognitive skills, and social and emotional skills. This term should only be used to describe children younger than five years of age. Evidence: PCS. Frequency: 4/4. (PMID:33783914)
- Ataxia (HP:0001251): Ataxia refers to impaired coordination of voluntary muscle movement. Cerebellar ataxia refers to ataxia due to dysfunction of the cerebellum. This causes a variety of elementary neurological deficits including asynergy (lack of coordination between muscles, limbs and joints), dysmetria (lack of ability to judge distances that can lead to under- or overshoot in grasping movements), and dysdiadochokinesia (inability to perform rapid movements requiring antagonizing muscle groups to be switched on and off repeatedly). Evidence: PCS. Frequency: 4/4. (PMID:33783914)
- Intention tremor (HP:0002080): A type of kinetic tremor that occurs during target directed movement is called intention tremor. That is, an oscillatory cerebellar ataxia that tends to be absent when the limbs are inactive and during the first part of voluntary movement but worsening as the movement continues and greater precision is required (e.g., in touching a target such as the patient's nose or a physician's finger). Evidence: PCS. Frequency: 4/4. (PMID:33783914)
- Nystagmus (HP:0000639): Rhythmic, involuntary oscillations of one or both eyes related to abnormality in fixation, conjugate gaze, or vestibular mechanisms. Evidence: PCS. Frequency: 1/4. (PMID:33783914)
- Ankyloglossia (HP:0010296): Short or anteriorly attached lingual frenulum, associated with limited mobility of the tongue. Evidence: PCS. Frequency: 1/4. (PMID:33783914)
- Chronic constipation (HP:0012450): Constipation for longer than three months with fewer than 3 bowel movements per week, straining, lumpy or hard stools, and a sensation of anorectal obstruction or incomplete defecation. Evidence: PCS. Frequency: 1/4. (PMID:33783914)
- Speech apraxia (HP:0011098): A type of apraxia that is characterized by difficulty or inability to execute speech movements because of problems with coordination and motor problems, leading to incorrect articulation. An increase of errors with increasing word and phrase length may occur. Evidence: PCS. Frequency: 1/4. (PMID:33783914)
- Esotropia (HP:0000565): A form of strabismus with one or both eyes turned inward ('crossed') to a relatively severe degree, usually defined as 10 diopters or more. Evidence: PCS. Frequency: 3/4. (PMID:33783914)
- Autosomal dominant inheritance (HP:0000006): A mode of inheritance that is observed for traits related to a gene encoded on one of the autosomes (i.e., the human chromosomes 1-22) in which a trait manifests in heterozygotes. In the context of medical genetics, an autosomal dominant disorder is caused when a single copy of the mutant allele is present. Males and females are affected equally, and can both transmit the disorder with a risk of 50% for each child of inheriting the mutant allele. Evidence: PCS. (PMID:33783914)